Phenotypes associated with the disease Plummer-Vinson syndrome (ORPHA:54028):
- Iron deficiency anemia (HP:0001891). Evidence: TAS. Frequency: Obligate (HP:0040280). (ORPHA:54028)
- Dysphagia (HP:0002015): Difficulty in swallowing. Evidence: TAS. Frequency: Obligate (HP:0040280). (ORPHA:54028)
- Hypochromic microcytic anemia (HP:0004840): A type of anemia characterized by an abnormally low concentration of hemoglobin in the erythrocytes and lower than normal size of the erythrocytes. Evidence: TAS. Frequency: Obligate (HP:0040280). (ORPHA:54028)
- Decreased circulating ferritin concentration (HP:0012343): Abnormally reduced concentration of ferritin, a ubiquitous intracellular protein that stores iron, in the blood. Evidence: TAS. Frequency: Obligate (HP:0040280). (ORPHA:54028)
- Esophageal web (HP:0100594): Thin (2-3mm) membranes of normal esophageal tissue consisting of mucosa and submucosa that can be congenital or acquired. Congenital webs commonly appear in the middle and inferior third of the esophagus, and they are more likely to be circumferential with a central or eccentric orifice. Acquired webs are much more common than congenital webs and typically appear in the cervical area (postcricoid). Clinical symptoms of this condition are selective (solid more than liquids) dysphagia, thoracic pain, nasopharyngeal reflux, aspiration, perforation and food impaction (the last two are very rare). Evidence: TAS. Frequency: Obligate (HP:0040280). (ORPHA:54028)
- Glossitis (HP:0000206): Inflammation of the tongue. Evidence: TAS. Frequency: Very frequent (HP:0040281). (ORPHA:54028)
- Pallor (HP:0000980): Abnormally pale skin. Evidence: TAS. Frequency: Very frequent (HP:0040281). (ORPHA:54028)
- Easy fatigability (HP:0003388): Increased susceptibility to fatigue. Evidence: TAS. Frequency: Very frequent (HP:0040281). (ORPHA:54028)
- Narrow mouth (HP:0000160): Distance between the commissures of the mouth more than 2 SD below the mean. Alternatively, an apparently decreased width of the oral aperture (subjective). Evidence: TAS. Frequency: Occasional (HP:0040283). (ORPHA:54028)
- Concave nail (HP:0001598): The natural longitudinal (posterodistal) convex arch is not present or is inverted. Evidence: TAS. Frequency: Occasional (HP:0040283). (ORPHA:54028)
- Abdominal pain (HP:0002027): An unpleasant sensation characterized by physical discomfort (such as pricking, throbbing, or aching) and perceived to originate in the abdomen. Evidence: TAS. Frequency: Occasional (HP:0040283). (ORPHA:54028)
- Poor appetite (HP:0004396): A reduced desire to eat. Evidence: TAS. Frequency: Occasional (HP:0040283). (ORPHA:54028)
- Intra-oral hyperpigmentation (HP:0010284): Increased pigmentation, either focal or generalized, of the mucosa of the mouth. Evidence: TAS. Frequency: Occasional (HP:0040283). (ORPHA:54028)
- Tongue atrophy (HP:0012473): Wasting of the tongue. Evidence: TAS. Frequency: Occasional (HP:0040283). (ORPHA:54028)
- Geophagia (HP:0025062): The practice of eating earth or soil-like substrates such as clay or chalk. Evidence: TAS. Frequency: Occasional (HP:0040283). (ORPHA:54028)
- Cheilitis (HP:0100825): Inflammation of the lip. Evidence: TAS. Frequency: Occasional (HP:0040283). (ORPHA:54028)